- Short stature (HP:0004322): A height below that which is expected according to age and gender norms. Although there is no universally accepted definition of short stature, many refer to "short stature" as height more than 2 standard deviations below the mean for age and gender (or below the 3rd percentile for age and gender dependent norms). Evidence: PCS. Frequency: 1/1. (PMID:35904126)
- Short palpebral fissure (HP:0012745): Distance between the medial and lateral canthi is more than 2 SD below the mean for age (objective); or, apparently reduced length of the palpebral fissures. Evidence: PCS. Frequency: 2/2. (PMID:35904126)
- Ankyloglossia (HP:0010296): Short or anteriorly attached lingual frenulum, associated with limited mobility of the tongue. Evidence: PCS. Frequency: 1/1. (PMID:35904126)
- Thick vermilion border (HP:0012471): Increased width of the skin of vermilion border region of upper lip. Evidence: PCS. Frequency: 1/1. (PMID:35904126)
- Lumbar hyperlordosis (HP:0002938): An abnormal accentuation of the inward curvature of the spine in the lumbar region. Evidence: PCS. Frequency: 1/1. (PMID:35904126)
- Long palpebral fissure (HP:0000637): Distance between medial and lateral canthi is more than two standard deviations above the mean for age (objective); or, apparently increased length of the palpebral fissures. Evidence: PCS. Frequency: 1/1. (PMID:35904126)
- Constipation (HP:0002019): Infrequent or difficult evacuation of feces. Evidence: PCS. Frequency: 1/1. (PMID:35904126)
- Prominent interphalangeal joints (HP:0006237). Evidence: PCS. Frequency: 1/1. (PMID:35904126)
- Posteriorly rotated ears (HP:0000358): A type of abnormal location of the ears in which the position of the ears is characterized by posterior rotation (the superior part of the ears is rotated towards the back of the head, and the inferior part of the ears towards the front). Evidence: PCS. Frequency: 2/2. (PMID:35904126)
- Melanocytic nevus (HP:0000995): A oval and round, colored (usually medium-to dark brown, reddish brown, or flesh colored) lesion. Typically, a melanocytic nevus is less than 6 mm in diameter, but may be much smaller or larger. Evidence: PCS. Frequency: 1/1. (PMID:35904126)
- Highly arched eyebrow (HP:0002553): Increased height of the central portion of the eyebrow, forming a crescent, semicircular, or inverted U shape. Evidence: PCS. Frequency: 5/5. (PMID:35904126)
- Microcephaly (HP:0000252): Head circumference below 2 standard deviations below the mean for age and gender. Evidence: PCS. Frequency: 1/1. (PMID:35904126)
- Tall stature (HP:0000098): A height above that which is expected according to age and gender norms. Evidence: PCS. Frequency: 1/1. (PMID:35904126)
- Downslanted palpebral fissures (HP:0000494): The palpebral fissure inclination is more than two standard deviations below the mean. Evidence: PCS. Frequency: 1/1. (PMID:35904126)
- Deeply set eye (HP:0000490): An eye that is more deeply recessed into the plane of the face than is typical. Evidence: PCS. Frequency: 1/1. (PMID:35904126)
- 2-3 toe syndactyly (HP:0004691): Syndactyly with fusion of toes two and three. Evidence: PCS. Frequency: 1/1. (PMID:35904126)
- Self hugging (HP:0032521): Involuntary, tic-like movements consisted of crossing both arms across the chest and tensing the body or clasping the hands and squeezing the arms to the sides. The movements last a few seconds and may occur in series or flurries, generally accompanied by facial grimacing and occasional grunting. Evidence: PCS. Frequency: 1/1. (PMID:35904126)
- Axillary pterygium (HP:0001060): Presence of a cutaneous membrane (flap) in the armpit. Evidence: PCS. Frequency: 1/1. (PMID:35904126)
- Recurrent hand flapping (HP:0100023): A type of repetitive behavior in which the affected individual repeatedly waves the hands and/or arms rhythmically. Evidence: PCS. Frequency: 1/1. (PMID:35904126)
- Increased overbite (HP:0011094): Maxillary teeth cover the mandibular teeth when biting to an increased degree. The feature is defined as a vertical overlap of the maxillary incisors over the mandibular incisors that exceeds 2 mm. Evidence: PCS. Frequency: 1/1. (PMID:35904126)
- Recurrent otitis media (HP:0000403): Increased susceptibility to otitis media, as manifested by recurrent episodes of otitis media. Evidence: PCS. Frequency: 1/1. (PMID:35904126)
- Thoracolumbar scoliosis (HP:0002944). Evidence: PCS. Frequency: 1/1. (PMID:35904126)
- Clinodactyly of the 5th finger (HP:0004209): Clinodactyly refers to a bending or curvature of the fifth finger in the radial direction (i.e., towards the 4th finger). Evidence: PCS. Frequency: 1/1. (PMID:35904126)
- Drooling (HP:0002307): Habitual flow of saliva out of the mouth. Evidence: PCS. Frequency: 2/2. (PMID:35904126)
- Conductive hearing impairment (HP:0000405): An abnormality of vibrational conductance of sound to the inner ear leading to impairment of sensory perception of sound. Evidence: PCS. Frequency: 1/1. (PMID:35904126)
- Macrotia (HP:0000400): Median longitudinal ear length greater than two standard deviations above the mean and median ear width greater than two standard deviations above the mean (objective); or, apparent increase in length and width of the pinna (subjective). Evidence: PCS. Frequency: 2/2. (PMID:35904126)
- Low-set ears (HP:0000369): Upper insertion of the ear to the scalp below an imaginary horizontal line drawn between the inner canthi of the eye and extending posteriorly to the ear. Evidence: PCS. Frequency: 1/1. (PMID:35904126)
- Autosomal dominant inheritance (HP:0000006): A mode of inheritance that is observed for traits related to a gene encoded on one of the autosomes (i.e., the human chromosomes 1-22) in which a trait manifests in heterozygotes. In the context of medical genetics, an autosomal dominant disorder is caused when a single copy of the mutant allele is present. Males and females are affected equally, and can both transmit the disorder with a risk of 50% for each child of inheriting the mutant allele. Evidence: PCS. (PMID:35904126)
- Upslanted palpebral fissure (HP:0000582): The palpebral fissure inclination is more than two standard deviations above the mean for age (objective); or, the inclination of the palpebral fissure is greater than typical for age. Evidence: PCS. Frequency: 2/2. (PMID:35904126)
- Deep philtrum (HP:0002002): Accentuated, prominent philtral ridges giving rise to an exaggerated groove in the midline between the nasal base and upper vermillion border. Evidence: PCS. Frequency: 3/3. (PMID:35904126)
- Anteverted nares (HP:0000463): Anteriorly-facing nostrils viewed with the head in the Frankfurt horizontal and the eyes of the observer level with the eyes of the subject. This gives the appearance of an upturned nose (upturned nasal tip). Evidence: PCS. Frequency: 1/1. (PMID:35904126)
- Short columella (HP:0002000): Reduced distance from the anterior border of the naris to the subnasale. Evidence: PCS. Frequency: 1/1. (PMID:35904126)
- Cleft soft palate (HP:0000185): Cleft of the soft palate (also known as the velum, or muscular palate) as a result of a developmental defect occurring between the 7th and 12th week of pregnancy. Cleft soft palate can cause functional abnormalities of the Eustachian tube with resulting middle ear anomalies and hearing difficulties, as well as speech problems associated with hypernasal speech due to velopharyngeal insufficiency. Evidence: PCS. Frequency: 1/1. (PMID:35904126)
- Feeding difficulties in infancy (HP:0008872): Impaired feeding performance of an infant as manifested by difficulties such as weak and ineffective sucking, brief bursts of sucking, and falling asleep during sucking. There may be difficulties with chewing or maintaining attention. Evidence: PCS. Frequency: 1/1. (PMID:35904126)
- High palate (HP:0000218): Height of the palate more than 2 SD above the mean (objective) or palatal height at the level of the first permanent molar more than twice the height of the teeth (subjective). Evidence: PCS. Frequency: 1/1. (PMID:35904126)
- Wide intermamillary distance (HP:0006610): A larger than usual distance between the left and right nipple. Evidence: PCS. Frequency: 1/1. (PMID:35904126)
- Thick lower lip vermilion (HP:0000179): Increased thickness of the lower lip, leading to a prominent appearance of the lower lip. The height of the vermilion of the lower lip in the midline is more than 2 SD above the mean. Alternatively, an apparently increased height of the vermilion of the lower lip in the frontal view (subjective). Evidence: PCS. Frequency: 1/1. (PMID:35904126)
- Cerebellar vermis atrophy (HP:0006855): Wasting (atrophy) of the vermis of cerebellum. Evidence: PCS. Frequency: 1/1. (PMID:35904126)
- Cerebellar vermis hypoplasia (HP:0001320): Underdevelopment of the vermis of cerebellum. Evidence: PCS. Frequency: 1/1. (PMID:35904126)
- Delayed speech and language development (HP:0000750): A degree of language development that is significantly below the norm for a child of a specified age. Evidence: PCS. Frequency: 6/6. (PMID:35904126)
- Long nose (HP:0003189): Distance from nasion to subnasale more than two standard deviations above the mean, or alternatively, an apparently increased length from the nasal root to the nasal base. Evidence: PCS. Frequency: 2/2. (PMID:35904126)
- Scoliosis (HP:0002650): The presence of an abnormal lateral curvature of the spine. Evidence: PCS. Frequency: 1/1. (PMID:35904126)
- Everted lower lip vermilion (HP:0000232): An abnormal configuration of the lower lip such that it is turned outward i.e., everted, with the Inner aspect of the lower lip vermilion (normally opposing the teeth) being visible in a frontal view. Evidence: PCS. Frequency: 1/1. (PMID:35904126)
- Febrile seizure (within the age range of 3 months to 6 years) (HP:0002373): A febrile seizure is any type of seizure (most often a generalized tonic-clonic seizure) occurring with fever (at least 38 degrees Celsius) but in the absence of central nervous system infection, severe metabolic disturbance or other alternative precipitant in children between the ages of 3 months and 6 years. Evidence: PCS. Frequency: 2/2. (PMID:35904126)
- Hydroureter (HP:0000072): The distention of the ureter with urine. Evidence: PCS. Frequency: 1/1. (PMID:35904126)
- Epiblepharon (HP:0011225): Redundant eyelid skin pressing the eyelashes against the cornea and/or conjunctiva. Evidence: PCS. Frequency: 1/1. (PMID:35904126)
- Kyphosis (HP:0002808): Exaggerated anterior convexity of the thoracic vertebral column. Evidence: PCS. Frequency: 1/1. (PMID:35904126)
- Aortic aneurysm (HP:0004942): Aortic dilatation refers to a dimension that is greater than the 95th percentile for the normal person age, sex and body size. In contrast, an aneurysm is defined as a localized dilation of the aorta that is more than 150 percent of predicted (ratio of observed to expected diameter 1.5 or more). Aneurysm should be distinguished from ectasia, which represents a diffuse dilation of the aorta less than 50 percent of normal aorta diameter. Evidence: PCS. Frequency: 1/1. (PMID:35904126)
- Self-mutilation (HP:0000742): Deliberate harm to one's body resulting in tissue damage, without a conscious intent to die. Evidence: PCS. Frequency: 1/1. (PMID:35904126)
- Mild intellectual disability (HP:0001256): Mild intellectual disability (ID) is defined as a type of ID characterized by mildly sub-average adaptive functioning and intellectual functioning, with an intelligence quotient (IQ) the range of 50-69. Evidence: PCS. Frequency: 1/1. (PMID:35904126)
- Limited elbow extension (HP:0001377): Limited ability to straighten the arm at the elbow joint. Evidence: PCS. Frequency: 1/1. (PMID:35904126)
- Moderate intellectual disability (HP:0002342): Moderate intellectual disability (ID) is defined as a type of ID characterized by moderately sub-average adaptive functioning and intellectual functioning, with an intelligence quotient (IQ) the range of 35-49. Evidence: PCS. Frequency: 1/1. (PMID:35904126)
- Seizure (HP:0001250): A seizure is an intermittent abnormality of nervous system physiology characterized by a transient occurrence of signs and/or symptoms due to abnormal excessive or synchronous neuronal activity in the brain. Evidence: PCS. Frequency: 0/3. (PMID:35904126)
- Apraxia (HP:0002186): A defect in the understanding of complex motor commands and in the execution of certain learned movements, i.e., deficits in the cognitive components of learned movements. Evidence: PCS. Frequency: 1/1. (PMID:35904126)
- Flexion contracture (HP:0001371): A flexion contracture is a bent (flexed) joint that cannot be straightened actively or passively. It is thus a chronic loss of joint motion due to structural changes in muscle, tendons, ligaments, or skin that prevents normal movement of joints. Evidence: PCS. Frequency: 1/1. (PMID:35904126)
- Hypotonia (HP:0001252): Hypotonia is an abnormally low muscle tone (the amount of tension or resistance to movement in a muscle). Even when relaxed, muscles have a continuous and passive partial contraction which provides some resistance to passive stretching. Hypotonia thus manifests as diminished resistance to passive stretching. Hypotonia is not the same as muscle weakness, although the two conditions can co-exist. Evidence: PCS. Frequency: 1/1. (PMID:35904126)
- U-Shaped upper lip vermilion (HP:0010806): Gentle upward curve of the upper lip vermilion such that the center is placed well superior to the commissures. Evidence: PCS. Frequency: 1/1. (PMID:35904126)
- Pica (HP:0011856): An appetite for and the persistent ingestion of non-food substances such as clay. In order to diagnose pica, this behavior must have persisted over a period of at least one month. Evidence: PCS. Frequency: 1/1. (PMID:35904126)
- Excessive shyness (HP:0100962): Atypically high degree of awkwardness or apprehension experienced when approaching or being approached by others. Evidence: PCS. Frequency: 3/3. (PMID:35904126)
- Cafe-au-lait spot (HP:0000957): Cafe-au-lait spots are hyperpigmented lesions that can vary in color from light brown to dark brown with smooth borders and having a size of 1.5 cm or more in adults and 0.5 cm or more in children. Evidence: PCS. Frequency: 1/1. (PMID:35904126)
- Smooth philtrum (HP:0000319): Flat skin surface, with no ridge formation in the central region of the upper lip between the nasal base and upper vermilion border. Evidence: PCS. Frequency: 1/1. (PMID:35904126)
- Aggressive behavior (HP:0000718): Behavior or an act aimed at harming a person, animal, or physical property (e.g., acts of physical violence; shouting, swearing, and using harsh language; slashing someone's tires). Evidence: PCS. Frequency: 1/1. (PMID:35904126)
- Young adult onset (HP:0011462): Onset of disease at the age of between 16 and 40 years. Evidence: PCS. Frequency: 1/1. (PMID:35904126)
- Autism (HP:0000717): Autism is a neurodevelopmental disorder characterized by impaired social interaction and communication, and by restricted and repetitive behavior. Autism begins in childhood. It is marked by the presence of markedly abnormal or impaired development in social interaction and communication and a markedly restricted repertoire of activity and interest. Manifestations of the disorder vary greatly depending on the developmental level and chronological age of the individual (DSM-IV). Evidence: PCS. Frequency: 1/3. (PMID:35904126)
- Hyperlordosis (HP:0003307): Abnormally increased curvature (anterior concavity) of the lumbar or cervical spine. Evidence: PCS. Frequency: 1/1. (PMID:35904126)
- Delayed ability to sit (HP:0025336): A failure to achieve the ability to sit at an appropriate developmental stage. Most children sit with support at 6 months of age and sit steadily without support at 9 months of age. Evidence: PCS. Frequency: 4/5. (PMID:35904126)
- Retrognathia (HP:0000278): An abnormality in which the mandible is mislocalised posteriorly. Evidence: PCS. Frequency: 2/2. (PMID:35904126)
- Pes planus (HP:0001763): A foot where the longitudinal arch of the foot is in contact with the ground or floor when the individual is standing; or, in a patient lying supine, a foot where the arch is in contact with the surface of a flat board pressed against the sole of the foot by the examiner with a pressure similar to that expected from weight bearing; or, the height of the arch is reduced. Evidence: PCS. Frequency: 1/1. (PMID:35904126)
- Intellectual disability (HP:0001249): The term intellectual disability or intellectual developmental disorder is used to describe significantly sub-average intellectual and adaptive functioning based on clinical assessment and as measured by individually administered, appropriately normed, standardized and validated tests of intellectual functioning and adaptive behavior, with onset during the developmental period from infancy through adolescence. Evidence: PCS. Frequency: 5/6. (PMID:35904126)
- Thick eyebrow (HP:0000574): Increased density/number and/or increased diameter of eyebrow hairs. Evidence: PCS. Frequency: 1/1. (PMID:35904126)
- Expressive language delay (HP:0002474): A delay in the acquisition of the ability to use language to communicate needs, wishes, or thoughts. Evidence: PCS. Frequency: 1/1. (PMID:35904126)
- Short chin (HP:0000331): Decreased vertical distance from the vermilion border of the lower lip to the inferior-most point of the chin. Evidence: PCS. Frequency: 1/1. (PMID:35904126)
- Delayed skeletal maturation (HP:0002750): A decreased rate of skeletal maturation. Delayed skeletal maturation can be diagnosed on the basis of an estimation of the bone age from radiographs of specific bones in the human body. Evidence: PCS. Frequency: 1/1. (PMID:35904126)
- Joint hypermobility (HP:0001382): The capability that a joint (or a group of joints) has to move, passively and/or actively, beyond normal limits along physiological axes. Evidence: PCS. Frequency: 3/3. (PMID:35904126)
- Premature adrenarche (HP:0012412): Onset of adrenarche at an earlier age than usual. Evidence: PCS. Frequency: 1/1. (PMID:35904126)
- Knee flexion contracture (HP:0006380): A type of knee joint contracture in which the knee is in a fixed bent (flexed) configuration such that it cannot be straightened actively or passively. Evidence: PCS. Frequency: 1/1. (PMID:35904126)
- Autistic behavior (HP:0000729): Persistent deficits in social interaction and communication and interaction as well as a markedly restricted repertoire of activity and interest as well as repetitive patterns of behavior. Evidence: PCS. Frequency: 2/2. (PMID:35904126)
- Prominent nose (HP:0000448): Distance between subnasale and pronasale more than two standard deviations above the mean, or alternatively, an apparently increased anterior protrusion of the nasal tip. Evidence: PCS. Frequency: 1/1. (PMID:35904126)
- Bilateral single transverse palmar creases (HP:0007598): The distal and proximal transverse palmar creases are merged into a single transverse palmar crease on both hands. Evidence: PCS. Frequency: 1/1. (PMID:35904126)
- Convex nasal ridge (HP:0000444): Nasal ridge curving anteriorly to an imaginary line that connects the nasal root and tip. The nose appears often also prominent, and the columella low. Evidence: PCS. Frequency: 3/3. (PMID:35904126)
- Spasticity (HP:0001257): A motor disorder characterized by a velocity-dependent increase in tonic stretch reflexes with increased muscle tone, exaggerated (hyperexcitable) tendon reflexes. Evidence: PCS. Frequency: 1/1. (PMID:35904126)
- Short philtrum (HP:0000322): Distance between nasal base and midline upper lip vermilion border more than 2 SD below the mean. Alternatively, an apparently decreased distance between nasal base and midline upper lip vermilion border. Evidence: PCS. Frequency: 2/2. (PMID:35904126)
- Broad philtrum (HP:0000289): Distance between the philtral ridges, measured just above the vermilion border, more than 2 standard deviations above the mean, or alternatively, an apparently increased distance between the ridges of the philtrum. Evidence: PCS. Frequency: 1/1. (PMID:35904126)
- Wide nose (HP:0000445): Interalar distance more than two standard deviations above the mean for age, i.e., an apparently increased width of the nasal base and alae. Evidence: PCS. Frequency: 1/1. (PMID:35904126)
- Widely spaced teeth (HP:0000687): Increased spaces (diastemata) between most of the teeth in the same dental arch. Evidence: PCS. Frequency: 1/1. (PMID:35904126)
- Hypermetropia (HP:0000540): An abnormality of refraction characterized by the ability to see objects in the distance clearly, while objects nearby appear blurry. Evidence: PCS. Frequency: 2/2. (PMID:35904126)
- Inguinal hernia (HP:0000023): Protrusion of the contents of the abdominal cavity through the inguinal canal. Evidence: PCS. Frequency: 1/1. (PMID:35904126)
- Anteverted ears (HP:0040080). Evidence: PCS. Frequency: 1/1. (PMID:35904126)
- Increased arm span (HP:0012771): Increased length of the arm span (length from one end of an individual's arms measured at the fingertips to the other when raised parallel to the ground at shoulder height at a one-hundred eighty degree angle). Evidence: PCS. Frequency: 1/1. (PMID:35904126)
- Microtia (HP:0008551): Underdevelopment of the external ear. Evidence: PCS. Frequency: 1/1. (PMID:35904126)
- Toe clinodactyly (HP:0001863): Bending or curvature of a toe in the tibial direction (i.e., towards the big toe). Evidence: PCS. Frequency: 2/2. (PMID:35904126)
- Narrow chest (HP:0000774): Reduced width of the chest from side to side, associated with a reduced distance from the sternal notch to the tip of the shoulder. Evidence: PCS. Frequency: 1/1. (PMID:35904126)
- Wide nasal bridge (HP:0000431): Increased breadth of the nasal bridge (and with it, the nasal root). Evidence: PCS. Frequency: 1/1. (PMID:35904126)
- Delayed ability to walk (HP:0031936): A failure to achieve the ability to walk at an appropriate developmental stage. Most children learn to walk in a series of stages, and learn to walk short distances independently between 12 and 15 months. Evidence: PCS. Frequency: 3/3. (PMID:35904126)
- Underdeveloped nasal alae (HP:0000430): Thinned, deficient, or excessively arched ala nasi. Evidence: PCS. Frequency: 1/1. (PMID:35904126)
- Narrow palpebral fissure (HP:0045025): Reduction in the vertical distance between the upper and lower eyelids. Evidence: PCS. Frequency: 1/1. (PMID:35904126)
- External tibial torsion (HP:0034373): External twisting of the tibia resulting in the toes of each foot pointing outward (outtoeing) . Evidence: PCS. Frequency: 1/1. (PMID:35904126)
- Prominent nasal bridge (HP:0000426): Anterior positioning of the nasal root in comparison to the usual positioning for age. Evidence: PCS. Frequency: 4/4. (PMID:35904126)
- Tip-toe gait (HP:0030051): An abnormal gait pattern characterized by the failure of the heel to contact the floor at the onset of stance during gait. Evidence: PCS. Frequency: 1/1. (PMID:35904126)
- Synophrys (HP:0000664): Meeting of the medial eyebrows in the midline. Evidence: PCS. Frequency: 1/1. (PMID:35904126)
- Cryptorchidism (HP:0000028): Testis in inguinal canal. That is, absence of one or both testes from the scrotum owing to failure of the testis or testes to descend through the inguinal canal to the scrotum. Evidence: PCS. Frequency: 1/1. (PMID:35904126)
These phenotypes are associated with the disease intellectual developmental disorder, autosomal dominant 73 (OMIM:620450).